Phenotypes associated with the disease hearing loss, autosomal recessive 106 (OMIM:617637):
- Hearing impairment (HP:0000365): A decreased magnitude of the sensory perception of sound. Evidence: PCS. Frequency: 2/2. Onset: Childhood onset (HP:0011463). (PMID:26282398)
- Autosomal recessive inheritance (HP:0000007): A mode of inheritance that is observed for traits related to a gene encoded on one of the autosomes (i.e., the human chromosomes 1-22) in which a trait manifests in individuals with two pathogenic alleles, either homozygotes (two copies of the same mutant allele) or compound heterozygotes (whereby each copy of a gene has a distinct mutant allele). Evidence: PCS. (PMID:26282398)